Phenotypes associated with the disease Micro syndrome (ORPHA:2510):
- Posteriorly rotated ears (HP:0000358): A type of abnormal location of the ears in which the position of the ears is characterized by posterior rotation (the superior part of the ears is rotated towards the back of the head, and the inferior part of the ears towards the front). Evidence: TAS. Frequency: Frequent (HP:0040282). (ORPHA:2510)
- Cryptorchidism (HP:0000028): Testis in inguinal canal. That is, absence of one or both testes from the scrotum owing to failure of the testis or testes to descend through the inguinal canal to the scrotum. Evidence: TAS. Frequency: Very frequent (HP:0040281). (ORPHA:2510)
- High palate (HP:0000218): Height of the palate more than 2 SD above the mean (objective) or palatal height at the level of the first permanent molar more than twice the height of the teeth (subjective). Evidence: TAS. Frequency: Very frequent (HP:0040281). (ORPHA:2510)
- Microcephaly (HP:0000252): Head circumference below 2 standard deviations below the mean for age and gender. Evidence: TAS. Frequency: Very frequent (HP:0040281). (ORPHA:2510)
- Short philtrum (HP:0000322): Distance between nasal base and midline upper lip vermilion border more than 2 SD below the mean. Alternatively, an apparently decreased distance between nasal base and midline upper lip vermilion border. Evidence: TAS. Frequency: Very frequent (HP:0040281). (ORPHA:2510)
- Wide nasal bridge (HP:0000431): Increased breadth of the nasal bridge (and with it, the nasal root). Evidence: TAS. Frequency: Very frequent (HP:0040281). (ORPHA:2510)
- Anteverted nares (HP:0000463): Anteriorly-facing nostrils viewed with the head in the Frankfurt horizontal and the eyes of the observer level with the eyes of the subject. This gives the appearance of an upturned nose (upturned nasal tip). Evidence: TAS. Frequency: Very frequent (HP:0040281). (ORPHA:2510)
- Microcornea (HP:0000482): A congenital abnormality of the cornea in which the cornea and the anterior segment of the eye are smaller than normal. The horizontal diameter of the cornea does not reach 10 mm even in adulthood. Evidence: TAS. Frequency: Very frequent (HP:0040281). (ORPHA:2510)
- Cataract (HP:0000518): A cataract is an opacity or clouding that develops in the crystalline lens of the eye or in its capsule. Evidence: TAS. Frequency: Very frequent (HP:0040281). (ORPHA:2510)
- Microphthalmia (HP:0000568): A developmental anomaly characterized by abnormal smallness of one or both eyes. Evidence: TAS. Frequency: Very frequent (HP:0040281). (ORPHA:2510)
- Optic atrophy (HP:0000648): Atrophy of the optic nerve. Optic atrophy results from the death of the retinal ganglion cell axons that comprise the optic nerve and manifesting as a pale optic nerve on fundoscopy. Evidence: TAS. Frequency: Very frequent (HP:0040281). (ORPHA:2510)
- Delayed puberty (HP:0000823): Passing the age when puberty normally occurs with no physical or hormonal signs of the onset of puberty. Evidence: TAS. Frequency: Very frequent (HP:0040281). (ORPHA:2510)
- Hypotonia (HP:0001252): Hypotonia is an abnormally low muscle tone (the amount of tension or resistance to movement in a muscle). Even when relaxed, muscles have a continuous and passive partial contraction which provides some resistance to passive stretching. Hypotonia thus manifests as diminished resistance to passive stretching. Hypotonia is not the same as muscle weakness, although the two conditions can co-exist. Evidence: TAS. Frequency: Very frequent (HP:0040281). (ORPHA:2510)
- Spasticity (HP:0001257): A motor disorder characterized by a velocity-dependent increase in tonic stretch reflexes with increased muscle tone, exaggerated (hyperexcitable) tendon reflexes. Evidence: TAS. Frequency: Very frequent (HP:0040281). (ORPHA:2510)
- Global developmental delay (HP:0001263): A delay in the achievement of motor or mental milestones in the domains of development of a child, including motor skills, speech and language, cognitive skills, and social and emotional skills. This term should only be used to describe children younger than five years of age. Evidence: TAS. Frequency: Very frequent (HP:0040281). (ORPHA:2510)
- Pachygyria (HP:0001302): Pachygyria is a malformation of cortical development with abnormally wide gyri with sulci 1,5-3 cm apart and abnormally thick cortex measuring more than 5 mm (radiological definition). See also neuropathological definitions for 2-, 3-, and 4-layered lissencephaly. Evidence: TAS. Frequency: Very frequent (HP:0040281). (ORPHA:2510)
- Lissencephaly (HP:0001339): A spectrum of malformations of cortical development caused by insufficient neuronal migration that subsumes the terms agyria, pachygyria and subcortical band heterotopia. See also neuropathological definitions for 2-, 3-, and 4-layered lissencephaly. Evidence: TAS. Frequency: Very frequent (HP:0040281). (ORPHA:2510)
- Joint stiffness (HP:0001387): Joint stiffness is a perceived sensation of tightness in a joint or joints when attempting to move them after a period of inactivity. Joint stiffness typically subsides over time. Evidence: TAS. Frequency: Very frequent (HP:0040281). (ORPHA:2510)
- Short nose (HP:0003196): Distance from nasion to subnasale more than two standard deviations below the mean, or alternatively, an apparently decreased length from the nasal root to the nasal tip. Evidence: TAS. Frequency: Very frequent (HP:0040281). (ORPHA:2510)
- Short stature (HP:0004322): A height below that which is expected according to age and gender norms. Although there is no universally accepted definition of short stature, many refer to "short stature" as height more than 2 standard deviations below the mean for age and gender (or below the 3rd percentile for age and gender dependent norms). Evidence: TAS. Frequency: Very frequent (HP:0040281). (ORPHA:2510)
- Aplasia/Hypoplasia of the corpus callosum (HP:0007370): Absence or underdevelopment of the corpus callosum. Evidence: TAS. Frequency: Very frequent (HP:0040281). (ORPHA:2510)
- Severe intellectual disability (HP:0010864): Severe intellectual disability (ID) is defined as a type of ID characterized by severely sub-average adaptive functioning and intellectual functioning, with an intelligence quotient (IQ) the range of 20-34. Evidence: TAS. Frequency: Very frequent (HP:0040281). (ORPHA:2510)
- Cerebral visual impairment (HP:0100704): A form of loss of vision caused by damage to the visual cortex rather than a defect in the eye. Evidence: TAS. Frequency: Very frequent (HP:0040281). (ORPHA:2510)
- Clitoral hypoplasia (HP:0000060): Developmental hypoplasia of the clitoris. Evidence: TAS. Frequency: Frequent (HP:0040282). (ORPHA:2510)
- Hypoplastic labia minora (HP:0000064). Evidence: TAS. Frequency: Frequent (HP:0040282). (ORPHA:2510)
- Micrognathia (HP:0000347): Developmental hypoplasia of the mandible. Evidence: TAS. Frequency: Frequent (HP:0040282). (ORPHA:2510)
- Macrotia (HP:0000400): Median longitudinal ear length greater than two standard deviations above the mean and median ear width greater than two standard deviations above the mean (objective); or, apparent increase in length and width of the pinna (subjective). Evidence: TAS. Frequency: Frequent (HP:0040282). (ORPHA:2510)
- Abnormality of visual evoked potentials (HP:0000649): An anomaly of visually evoked potentials (VEP), which are electrical potentials, initiated by brief visual stimuli, which are recorded from the scalp overlying the visual cortex. Evidence: TAS. Frequency: Frequent (HP:0040282). (ORPHA:2510)
- Intrauterine growth retardation (HP:0001511): An abnormal restriction of fetal growth with fetal weight below the tenth percentile for gestational age. Evidence: TAS. Frequency: Frequent (HP:0040282). (ORPHA:2510)
- Cerebral cortical atrophy (HP:0002120): Atrophy of the cortex of the cerebrum. Evidence: TAS. Frequency: Frequent (HP:0040282). (ORPHA:2510)
- Generalized hirsutism (HP:0002230): Abnormally increased hair growth over much of the entire body. Evidence: TAS. Frequency: Frequent (HP:0040282). (ORPHA:2510)
- Scoliosis (HP:0002650): The presence of an abnormal lateral curvature of the spine. Evidence: TAS. Frequency: Frequent (HP:0040282). (ORPHA:2510)
- Kyphosis (HP:0002808): Exaggerated anterior convexity of the thoracic vertebral column. Evidence: TAS. Frequency: Frequent (HP:0040282). (ORPHA:2510)
- Abnormal retinal pigmentation (HP:0007703): Any deviation from the normal pigmentation of the retina. Evidence: TAS. Frequency: Frequent (HP:0040282). (ORPHA:2510)
- Hypoplasia of penis (HP:0008736). Evidence: TAS. Frequency: Frequent (HP:0040282). (ORPHA:2510)
- Hydronephrosis (HP:0000126): Severe distention of the kidney with dilation of the renal pelvis and calices. Evidence: TAS. Frequency: Occasional (HP:0040283). (ORPHA:2510)
- Retinal coloboma (HP:0000480): A notch or cleft of the retina or choroid, located vertically below the optic disc. Evidence: TAS. Frequency: Occasional (HP:0040283). (ORPHA:2510)
- Seizure (HP:0001250): A seizure is an intermittent abnormality of nervous system physiology characterized by a transient occurrence of signs and/or symptoms due to abnormal excessive or synchronous neuronal activity in the brain. Evidence: TAS. Frequency: Occasional (HP:0040283). (ORPHA:2510)
- Abnormal cerebellum morphology (HP:0001317): Any structural abnormality of the cerebellum. Evidence: TAS. Frequency: Occasional (HP:0040283). (ORPHA:2510)
- Cerebellar vermis hypoplasia (HP:0001320): Underdevelopment of the vermis of cerebellum. Evidence: TAS. Frequency: Occasional (HP:0040283). (ORPHA:2510)
- Peripheral neuropathy (HP:0009830): Peripheral neuropathy is a general term for any disorder of the peripheral nervous system. The main clinical features used to classify peripheral neuropathy are distribution, type (mainly demyelinating versus mainly axonal), duration, and course. Evidence: TAS. Frequency: Occasional (HP:0040283). (ORPHA:2510)
- Abnormal localization of kidney (HP:0100542): An abnormal site of the kidney. Evidence: TAS. Frequency: Occasional (HP:0040283). (ORPHA:2510)